Phenotypes associated with the disease Harlequin syndrome (ORPHA:199282):
- Anhidrosis (HP:0000970): Inability to sweat. Evidence: TAS. Frequency: Frequent (HP:0040282). (ORPHA:199282)
- Pallor (HP:0000980): Abnormally pale skin. Evidence: TAS. Frequency: Frequent (HP:0040282). (ORPHA:199282)
- Horner syndrome (HP:0002277): An abnormality resulting from a lesion of the sympathetic nervous system characterized by a combination of unilateral ptosis, miosis, and often ipsilateral hypohidrosis and conjunctival injection. Evidence: TAS. Frequency: Frequent (HP:0040282). (ORPHA:199282)
- Flushing (HP:0031284): Recurrent episodes of redness of the skin together with a sensation of warmth or burning of the affected areas of skin. Evidence: TAS. Frequency: Frequent (HP:0040282). (ORPHA:199282)
- Coldness (HP:0033850): Relative coldness of a body part to palpitation, often acccompanied by feelings of coldness. Evidence: TAS. Frequency: Frequent (HP:0040282). (ORPHA:199282)
- Miosis (HP:0000616): Abnormal (non-physiological) constriction of the pupil. Evidence: TAS. Frequency: Occasional (HP:0040283). (ORPHA:199282)
- Unilateral ptosis (HP:0007687): A unilateral form of ptosis. Evidence: TAS. Frequency: Occasional (HP:0040283). (ORPHA:199282)
- Epiphora (HP:0009926): Abnormally increased lacrimation, that is, excessive tearing (watering eye). Evidence: TAS. Frequency: Occasional (HP:0040283). (ORPHA:199282)
- Cluster headache (HP:0012199): A type of headache characterized by repeated attacks of unilateral pain lasting 15 to 180 minutes and associated with local autonomic signs. Evidence: TAS. Frequency: Occasional (HP:0040283). (ORPHA:199282)
- Rhinorrhea (HP:0031417): Increased discharge of mucus from the nose. Evidence: TAS. Frequency: Occasional (HP:0040283). (ORPHA:199282)
Not associated with this disease:
- Sensory neuropathy (HP:0000763): Peripheral neuropathy affecting the sensory nerves. Evidence: TAS. (ORPHA:199282)
- Functional motor deficit (HP:0004302). Evidence: TAS. (ORPHA:199282)